- Joint hypermobility (HP:0001382): The capability that a joint (or a group of joints) has to move, passively and/or actively, beyond normal limits along physiological axes. Evidence: TAS. Frequency: Very frequent (HP:0040281). (ORPHA:2715)
- Renal insufficiency (HP:0000083): A reduction in the level of performance of the kidneys in areas of function comprising the concentration of urine, removal of wastes, the maintenance of electrolyte balance, homeostasis of blood pressure, and calcium metabolism. Evidence: TAS. Frequency: Very frequent (HP:0040281). (ORPHA:2715)
- Proteinuria (HP:0000093): Increased levels of protein in the urine. Evidence: TAS. Frequency: Very frequent (HP:0040281). (ORPHA:2715)
- Strabismus (HP:0000486): A misalignment of the eyes so that the visual axes deviate from bifoveal fixation. The classification of strabismus may be based on a number of features including the relative position of the eyes, whether the deviation is latent or manifest, intermittent or constant, concomitant or otherwise and according to the age of onset and the relevance of any associated refractive error. Evidence: TAS. Frequency: Very frequent (HP:0040281). (ORPHA:2715)
- Optic atrophy (HP:0000648): Atrophy of the optic nerve. Optic atrophy results from the death of the retinal ganglion cell axons that comprise the optic nerve and manifesting as a pale optic nerve on fundoscopy. Evidence: TAS. Frequency: Very frequent (HP:0040281). (ORPHA:2715)
- Hypotonia (HP:0001252): Hypotonia is an abnormally low muscle tone (the amount of tension or resistance to movement in a muscle). Even when relaxed, muscles have a continuous and passive partial contraction which provides some resistance to passive stretching. Hypotonia thus manifests as diminished resistance to passive stretching. Hypotonia is not the same as muscle weakness, although the two conditions can co-exist. Evidence: TAS. Frequency: Very frequent (HP:0040281). (ORPHA:2715)
- Choreoathetosis (HP:0001266): Involuntary movements characterized by both athetosis (inability to sustain muscles in a fixed position) and chorea (widespread jerky arrhythmic movements). Evidence: TAS. Frequency: Very frequent (HP:0040281). (ORPHA:2715)
- Profound intellectual disability (HP:0002187): Profound intellectual disability (ID) is defined as a type of ID characterized by profoundly sub-average adaptive functioning and intellectual functioning, with an intelligence quotient (IQ) below 20. Evidence: TAS. Frequency: Very frequent (HP:0040281). (ORPHA:2715)
- Abnormal retinal pigmentation (HP:0007703): Any deviation from the normal pigmentation of the retina. Evidence: TAS. Frequency: Very frequent (HP:0040281). (ORPHA:2715)
- Abnormal retinal vascular morphology (HP:0008046): A structural abnormality of retinal vasculature. Evidence: TAS. Frequency: Very frequent (HP:0040281). (ORPHA:2715)
- Glomerulopathy (HP:0100820): Inflammatory or noninflammatory diseases affecting the glomeruli of the nephron. Evidence: TAS. Frequency: Very frequent (HP:0040281). (ORPHA:2715)
- Wide mouth (HP:0000154): Distance between the oral commissures more than 2 SD above the mean. Alternatively, an apparently increased width of the oral aperture (subjective). Evidence: TAS. Frequency: Frequent (HP:0040282). (ORPHA:2715)
- Narrow face (HP:0000275): Bizygomatic (upper face) and bigonial (lower face) width are both more than 2 standard deviations below the mean (objective); or, an apparent reduction in the width of the upper and lower face (subjective). Evidence: TAS. Frequency: Frequent (HP:0040282). (ORPHA:2715)
- Mandibular prognathia (HP:0000303): Abnormal prominence of the chin related to increased length of the mandible. Evidence: TAS. Frequency: Frequent (HP:0040282). (ORPHA:2715)
- Macrotia (HP:0000400): Median longitudinal ear length greater than two standard deviations above the mean and median ear width greater than two standard deviations above the mean (objective); or, apparent increase in length and width of the pinna (subjective). Evidence: TAS. Frequency: Frequent (HP:0040282). (ORPHA:2715)
- Visual impairment (HP:0000505): Visual impairment (or vision impairment) is vision loss (of a person) to such a degree as to qualify as an additional support need through a significant limitation of visual capability resulting from either disease, trauma, or congenital or degenerative conditions that cannot be corrected by conventional means, such as refractive correction, medication, or surgery. Evidence: TAS. Frequency: Frequent (HP:0040282). (ORPHA:2715)
- Spasticity (HP:0001257): A motor disorder characterized by a velocity-dependent increase in tonic stretch reflexes with increased muscle tone, exaggerated (hyperexcitable) tendon reflexes. Evidence: TAS. Frequency: Frequent (HP:0040282). (ORPHA:2715)
- Spastic diplegia (HP:0001264): Spasticity (neuromuscular hypertonia) primarily in the muscles of the legs, hips, and pelvis. Evidence: TAS. Frequency: Frequent (HP:0040282). (ORPHA:2715)
- Hyperreflexia (HP:0001347): Hyperreflexia is the presence of hyperactive stretch reflexes of the muscles. Evidence: TAS. Frequency: Frequent (HP:0040282). (ORPHA:2715)
- Sandal gap (HP:0001852): A widely spaced gap between the first toe (the great toe) and the second toe. Evidence: TAS. Frequency: Frequent (HP:0040282). (ORPHA:2715)
- Short stature (HP:0004322): A height below that which is expected according to age and gender norms. Although there is no universally accepted definition of short stature, many refer to "short stature" as height more than 2 standard deviations below the mean for age and gender (or below the 3rd percentile for age and gender dependent norms). Evidence: TAS. Frequency: Frequent (HP:0040282). (ORPHA:2715)
- Aplasia/Hypoplasia of the cerebellum (HP:0007360). Evidence: TAS. Frequency: Frequent (HP:0040282). (ORPHA:2715)
- Malar prominence (HP:0010620): Prominence of the malar process of the maxilla and infraorbital area appreciated in profile and from in front of the face. Evidence: TAS. Frequency: Frequent (HP:0040282). (ORPHA:2715)
- Hypoplasia of the zygomatic bone (HP:0010669): Underdevelopment of the zygomatic bone. That is, a reduction in size of the zygomatic bone, including the zygomatic process of the temporal bone of the skull, which forms part of the zygomatic arch. Evidence: TAS. Frequency: Frequent (HP:0040282). (ORPHA:2715)
- Mask-like facies (HP:0000298): A lack of facial expression often with staring eyes and a slightly open mouth. Evidence: TAS. Frequency: Occasional (HP:0040283). (ORPHA:2715)
- Cataract (HP:0000518): A cataract is an opacity or clouding that develops in the crystalline lens of the eye or in its capsule. Evidence: TAS. Frequency: Occasional (HP:0040283). (ORPHA:2715)
- Hypopigmented skin patches (HP:0001053). Evidence: TAS. Frequency: Occasional (HP:0040283). (ORPHA:2715)
- Scoliosis (HP:0002650): The presence of an abnormal lateral curvature of the spine. Evidence: TAS. Frequency: Occasional (HP:0040283). (ORPHA:2715)
- Large earlobe (HP:0009748): Increased volume of the earlobe, that is, abnormally prominent ear lobules. Evidence: TAS. Frequency: Occasional (HP:0040283). (ORPHA:2715)
These phenotypes are associated with the disease Severe oculo-renal-cerebellar syndrome (ORPHA:2715).